Phenotypes associated with the disease autosomal dominant nonsyndromic hearing loss 25 (OMIM:605583):
- Abnormal vestibular function (HP:0001751): An abnormality of the functioning of the vestibular apparatus. Evidence: PCS. Frequency: 0/23. (PMID:18674745)
- Sensorineural hearing impairment (HP:0000407): A type of hearing impairment in one or both ears related to an abnormal functionality of the cochlear nerve. Evidence: PCS. Frequency: 23/23. (PMID:18674745)
- Adult onset (HP:0003581): Onset of disease manifestations in adulthood, defined here as at the age of 16 years or later. Evidence: PCS. (PMID:18674745)
- Autosomal dominant inheritance (HP:0000006): A mode of inheritance that is observed for traits related to a gene encoded on one of the autosomes (i.e., the human chromosomes 1-22) in which a trait manifests in heterozygotes. In the context of medical genetics, an autosomal dominant disorder is caused when a single copy of the mutant allele is present. Males and females are affected equally, and can both transmit the disorder with a risk of 50% for each child of inheriting the mutant allele. Evidence: PCS. (PMID:18674745)